Phenotypes associated with the disease Vulvovaginal gingival syndrome (ORPHA:83453):
- Gingivitis (HP:0000230): Inflammation of the gingiva. Evidence: TAS. Frequency: Obligate (HP:0040280). (ORPHA:83453)
- Abnormal female external genitalia morphology (HP:0000055): Any structural abnormality of the female external genitalia. Evidence: TAS. Frequency: Frequent (HP:0040282). (ORPHA:83453)
- Oral ulcer (HP:0000155): Erosion of the mucous mebrane of the mouth with local excavation of the surface, resulting from the sloughing of inflammatory necrotic tissue. Evidence: TAS. Frequency: Frequent (HP:0040282). (ORPHA:83453)
- Pruritus (HP:0000989): Pruritus is an itch or a sensation that makes a person want to scratch. This term refers to an abnormally increased disposition to experience pruritus. Evidence: TAS. Frequency: Frequent (HP:0040282). (ORPHA:83453)
- Parakeratosis (HP:0001036): Abnormal formation of the keratinocytes of the epidermis characterized by persistence of nuclei, incomplete formation of keratin, and moistness and swelling of the keratinocytes. Evidence: TAS. Frequency: Frequent (HP:0040282). (ORPHA:83453)
- Erythema (HP:0010783): Redness of the skin, caused by hyperemia of the capillaries in the lower layers of the skin. Evidence: TAS. Frequency: Frequent (HP:0040282). (ORPHA:83453)
- Abnormality of tumor necrosis factor secretion (HP:0011118): An abnormality in the production or cellular release of tumor necrosis factor. Evidence: TAS. Frequency: Frequent (HP:0040282). (ORPHA:83453)
- Pain (HP:0012531): An unpleasant sensory and emotional experience associated with actual or potential tissue damage, or described in terms of such damage. Evidence: TAS. Frequency: Frequent (HP:0040282). (ORPHA:83453)
- Food intolerance (HP:0012537): A detrimental reaction to a food, beverage, food additive, or compound found in foods that produces symptoms in one or more body organs and systems that is not mediated by an immune reaction. Evidence: TAS. Frequency: Frequent (HP:0040282). (ORPHA:83453)
- Epidermal acanthosis (HP:0025092): Diffuse hypertrophy or thickening of the stratum spinosum of the epidermis (prickle cell layer of the skin). Evidence: TAS. Frequency: Frequent (HP:0040282). (ORPHA:83453)
- Lichenification (HP:0100725): Thickening and hardening of the epidermis seen with exaggeration of normal skin lines. Evidence: TAS. Frequency: Frequent (HP:0040282). (ORPHA:83453)
- Skin erosion (HP:0200041): A discontinuity of the skin exhibiting incomplete loss of the epidermis, a lesion that is moist, circumscribed, and usually depressed. Evidence: TAS. Frequency: Frequent (HP:0040282). (ORPHA:83453)
- Ridged nail (HP:0001807): Longitudinal, linear prominences in the nail plate. Evidence: TAS. Frequency: Occasional (HP:0040283). (ORPHA:83453)